- Feeding difficulties in infancy (HP:0008872): Impaired feeding performance of an infant as manifested by difficulties such as weak and ineffective sucking, brief bursts of sucking, and falling asleep during sucking. There may be difficulties with chewing or maintaining attention. Evidence: TAS. Frequency: Very frequent (HP:0040281). (ORPHA:96186)
- Postnatal growth retardation (HP:0008897): Slow or limited growth after birth. Evidence: TAS. Frequency: Very frequent (HP:0040281). (ORPHA:96186)
- Triangular face (HP:0000325): Facial contour, as viewed from the front, triangular in shape, with breadth at the temples and tapering to a narrow chin. Evidence: TAS. Frequency: Frequent (HP:0040282). (ORPHA:96186)
- Hypotonia (HP:0001252): Hypotonia is an abnormally low muscle tone (the amount of tension or resistance to movement in a muscle). Even when relaxed, muscles have a continuous and passive partial contraction which provides some resistance to passive stretching. Hypotonia thus manifests as diminished resistance to passive stretching. Hypotonia is not the same as muscle weakness, although the two conditions can co-exist. Evidence: TAS. Frequency: Frequent (HP:0040282). (ORPHA:96186)
- Global developmental delay (HP:0001263): A delay in the achievement of motor or mental milestones in the domains of development of a child, including motor skills, speech and language, cognitive skills, and social and emotional skills. This term should only be used to describe children younger than five years of age. Evidence: TAS. Frequency: Frequent (HP:0040282). (ORPHA:96186)
- Intrauterine growth retardation (HP:0001511): An abnormal restriction of fetal growth with fetal weight below the tenth percentile for gestational age. Evidence: TAS. Frequency: Frequent (HP:0040282). (ORPHA:96186)
- Small for gestational age (HP:0001518): Smaller than normal size according to sex and gestational age related norms, defined as a weight below the 10th percentile for the gestational age. Evidence: TAS. Frequency: Frequent (HP:0040282). (ORPHA:96186)
- Oligohydramnios (HP:0001562): Diminished amniotic fluid volume in pregnancy. Evidence: TAS. Frequency: Frequent (HP:0040282). (ORPHA:96186)
- Short stature (HP:0004322): A height below that which is expected according to age and gender norms. Although there is no universally accepted definition of short stature, many refer to "short stature" as height more than 2 standard deviations below the mean for age and gender (or below the 3rd percentile for age and gender dependent norms). Evidence: TAS. Frequency: Frequent (HP:0040282). (ORPHA:96186)
- Decreased body weight (HP:0004325): Abnormally low body weight. Evidence: TAS. Frequency: Frequent (HP:0040282). (ORPHA:96186)
- Prominent forehead (HP:0011220): Forward prominence of the entire forehead, due to protrusion of the frontal bone. Evidence: TAS. Frequency: Frequent (HP:0040282). (ORPHA:96186)
- Clinodactyly (HP:0030084): An angulation of a digit at an interphalangeal joint in the plane of the palm (finger) or sole (toe). Evidence: TAS. Frequency: Frequent (HP:0040282). (ORPHA:96186)
- Reduced circulating growth hormone concentration (HP:0034323): Concentration of growth hormone in the blood circulation below normal limits. Evidence: TAS. Frequency: Frequent (HP:0040282). (ORPHA:96186)
- Micrognathia (HP:0000347): Developmental hypoplasia of the mandible. Evidence: TAS. Frequency: Occasional (HP:0040283). (ORPHA:96186)
- Asymmetric growth (HP:0100555): A growth pattern that displays an abnormal difference between the left and the right side. Evidence: TAS. Frequency: Occasional (HP:0040283). (ORPHA:96186)
These phenotypes are associated with the disease Maternal uniparental disomy of chromosome 20 syndrome (ORPHA:96186).